- Abnormality of the endocrine system (HP:0000818): An abnormality of the endocrine system. Evidence: IEA. (OMIM:114580)
- Alopecia (HP:0001596): A noncongenital process of hair loss, which may progress to partial or complete baldness. Evidence: IEA. (OMIM:114580)
- Premature loss of teeth (HP:0006480): Exfoliation of a tooth more than 2 SD earlier than the normal age for the deciduous teeth and not related to traume or neglect. Exfoliation of a permanent tooth is per se abnormal. Evidence: TAS. (OMIM:114580)
- Recurrent mucocutaneous candidiasis (HP:0002728): Recurrent or persistent superficial Candida infections of the skin, mucous membranes, and nails. Evidence: IEA. (OMIM:114580)
- Recurrent viral infections (HP:0004429): Increased susceptibility to viral infections as manifested by recurrent episodes of viral infection. Evidence: IEA. (OMIM:114580)
- Cutaneous anergy (HP:0002965): Inability to react to a delayed hypersensitivity skin test. Evidence: IEA. (OMIM:114580)
- Autosomal dominant inheritance (HP:0000006): A mode of inheritance that is observed for traits related to a gene encoded on one of the autosomes (i.e., the human chromosomes 1-22) in which a trait manifests in heterozygotes. In the context of medical genetics, an autosomal dominant disorder is caused when a single copy of the mutant allele is present. Males and females are affected equally, and can both transmit the disorder with a risk of 50% for each child of inheriting the mutant allele. Evidence: IEA. (OMIM:114580)
These phenotypes are associated with the disease candidiasis, familial, 1 (OMIM:114580).